- Hypospadias (HP:0000047): Abnormal position of urethral meatus on the ventral penile shaft (underside) characterized by displacement of the urethral meatus from the tip of the glans penis to the ventral surface of the penis, scrotum, or perineum. Evidence: TAS. Frequency: Very frequent (HP:0040281). (ORPHA:3176)
- Spina bifida (HP:0002414): Incomplete closure of the embryonic neural tube, whereby some vertebral arches remain unfused and open. The mildest form is spina bifida occulta, followed by meningocele and meningomyelocele. Evidence: TAS. Frequency: Very frequent (HP:0040281). (ORPHA:3176)
- Spinal dysraphism (HP:0010301): A heterogeneous group of congenital spinal anomalies that result from defective closure of the neural tube early in fetal life. Evidence: TAS. Frequency: Very frequent (HP:0040281). (ORPHA:3176)
These phenotypes are associated with the disease Spina bifida-hypospadias syndrome (ORPHA:3176).